- Weight loss (HP:0001824): Reduction of total body weight. Evidence: TAS. Frequency: Occasional (HP:0040283). (ORPHA:2126)
- Neoplasm (HP:0002664): An organ or organ-system abnormality that consists of uncontrolled autonomous cell-proliferation which can occur in any part of the body as a benign or malignant neoplasm (tumor). Evidence: TAS. Frequency: Occasional (HP:0040283). (ORPHA:2126)
- Genital neoplasm (HP:0010787): A tumor (abnormal growth of tissue) of the genital system. Evidence: TAS. Frequency: Occasional (HP:0040283). (ORPHA:2126)
- Fatigue (HP:0012378): A subjective feeling of tiredness characterized by a lack of energy and motivation. Evidence: TAS. Frequency: Occasional (HP:0040283). (ORPHA:2126)
- Soft tissue neoplasm (HP:0031459): A tumor (abnormal growth of tissue) that arises from the soft tissue. The most common types are lipomatous (fatty), vascular, smooth muscle, fibrous, and fibrohistiocytic neoplasms. Evidence: TAS. Frequency: Occasional (HP:0040283). (ORPHA:2126)
- Neoplasia of the pleura (HP:0100527). Evidence: TAS. Frequency: Occasional (HP:0040283). (ORPHA:2126)
- Urinary retention (HP:0000016): Inability to completely empty the urinary bladder during the process of urination. Evidence: TAS. Frequency: Very rare (HP:0040284). (ORPHA:2126)
- Abnormal forehead morphology (HP:0000290): An anomaly of the forehead. Evidence: TAS. Frequency: Very rare (HP:0040284). (ORPHA:2126)
- Diplopia (HP:0000651): Diplopia is a condition in which a single object is perceived as two images, it is also known as double vision. Evidence: TAS. Frequency: Very rare (HP:0040284). (ORPHA:2126)
- Hypoglycemia (HP:0001943): A decreased concentration of glucose in the blood. Evidence: TAS. Frequency: Very rare (HP:0040284). (ORPHA:2126)
- Fever (HP:0001945): Body temperature elevated above the normal range. Evidence: TAS. Frequency: Very rare (HP:0040284). (ORPHA:2126)
- Recurrent hypoglycemia (HP:0001988): Recurrent episodes of decreased concentration of glucose in the blood. Evidence: TAS. Frequency: Very rare (HP:0040284). (ORPHA:2126)
- Constipation (HP:0002019): Infrequent or difficult evacuation of feces. Evidence: TAS. Frequency: Very rare (HP:0040284). (ORPHA:2126)
- Abnormal peritoneum morphology (HP:0002585): An abnormality of the peritoneum. Evidence: TAS. Frequency: Very rare (HP:0040284). (ORPHA:2126)
- Neoplasm of the liver (HP:0002896): A tumor (abnormal growth of tissue) of the liver. Evidence: TAS. Frequency: Very rare (HP:0040284). (ORPHA:2126)
- Low back pain (HP:0003419): An unpleasant sensation characterized by physical discomfort (such as pricking, throbbing, or aching) localized to the lower back. Evidence: TAS. Frequency: Very rare (HP:0040284). (ORPHA:2126)
- Neoplasm of the nervous system (HP:0004375): A tumor (abnormal growth of tissue) of the nervous system. Evidence: TAS. Frequency: Very rare (HP:0040284). (ORPHA:2126)
- Hypophosphatemic rickets (HP:0004912). Evidence: TAS. Frequency: Very rare (HP:0040284). (ORPHA:2126)
- Loss of consciousness (HP:0007185): Loss of awareness of oneself or one's surroundings, involving (i) a loss of normal motor control is evident as flaccidity or stiffness, either of which can be accompanied by jerking movements, and postural control is lost so that patients fall if they are in an upright position; (ii) normal responsiveness is lost; and (iii) the patient experiences amnesia for the event. Loss of consciousness my be transitory (e.g., syncope) or prolonged. Evidence: TAS. Frequency: Very rare (HP:0040284). (ORPHA:2126)
- Abnormal prostate morphology (HP:0008775): An abnormality of the prostate. Evidence: TAS. Frequency: Very rare (HP:0040284). (ORPHA:2126)
- Uterine neoplasm (HP:0010784): A tumor (abnormal growth of tissue) of the uterus. Evidence: TAS. Frequency: Very rare (HP:0040284). (ORPHA:2126)
- Prostate cancer (HP:0012125): A cancer of the prostate. Evidence: TAS. Frequency: Very rare (HP:0040284). (ORPHA:2126)
- Night sweats (HP:0030166): Occurrence of excessive sweating during sleep. Evidence: TAS. Frequency: Very rare (HP:0040284). (ORPHA:2126)
- Decreased circulating C-peptide concentration (HP:0030795): The concentration of C-peptide in the blood circulation is below the lower limit of normal. Evidence: TAS. Frequency: Very rare (HP:0040284). (ORPHA:2126)
- Pelvic mass (HP:0031501): An abnormal enlargement or swelling in the pelvic region. Evidence: TAS. Frequency: Very rare (HP:0040284). (ORPHA:2126)
- Hypoinsulinemia (HP:0040216): A decreased concentration of insulin in the blood. Evidence: TAS. Frequency: Very rare (HP:0040284). (ORPHA:2126)
- Abnormal mediastinum morphology (HP:0045026): Any structural anomaly of the central compartment of the thoracic cavity. Evidence: TAS. Frequency: Very rare (HP:0040284). (ORPHA:2126)
- Neoplasm of the lung (HP:0100526): Tumor of the lung. Evidence: TAS. Frequency: Very rare (HP:0040284). (ORPHA:2126)
- Vaginal neoplasm (HP:0100650): A tumor (abnormal growth of tissue) of the vagina. Evidence: TAS. Frequency: Very rare (HP:0040284). (ORPHA:2126)
These phenotypes are associated with the disease Solitary fibrous tumor (ORPHA:2126).